Phenotypes associated with the disease fibromatosis, gingival, 5 (OMIM:617626):
- Juvenile onset (HP:0003621): Onset of signs or symptoms of disease between the age of 5 and 15 years. Evidence: PCS. Frequency: 2/8. (PMID:28686854)
- Childhood onset (HP:0011463): Onset of disease at the age of between 1 and 5 years. Evidence: PCS. Frequency: 6/8. (PMID:28686854)
- Abnormal sternum morphology (HP:0000766): An anomaly of the sternum, also known as the breastbone. Evidence: PCS. Frequency: 3/9. (PMID:28686854)
- Gingival fibromatosis (HP:0000169): The presence of fibrosis of the gingiva. Evidence: PCS. Frequency: 9/9. (PMID:28686854)
- Autosomal dominant inheritance (HP:0000006): A mode of inheritance that is observed for traits related to a gene encoded on one of the autosomes (i.e., the human chromosomes 1-22) in which a trait manifests in heterozygotes. In the context of medical genetics, an autosomal dominant disorder is caused when a single copy of the mutant allele is present. Males and females are affected equally, and can both transmit the disorder with a risk of 50% for each child of inheriting the mutant allele. Evidence: PCS. (PMID:28686854)